Phenotypes associated with the disease Placental site trophoblastic tumor (ORPHA:99928):
- Amenorrhea (HP:0000141): Absence of menses for an interval of time equivalent to a total of more than (or equal to) 3 previous cycles or 6 months. Evidence: TAS. Frequency: Very frequent (HP:0040281). (ORPHA:99928)
- Miscarriage (HP:0005268): A pregnancy that ends at a stage in which the fetus is incapable of surviving on its own, defined as the spontaneous loss of a fetus before the 22th week of pregnancy. Evidence: TAS. Frequency: Very frequent (HP:0040281). (ORPHA:99928)
- Low maternal circulating chorionic gonadotropin concentration (HP:0011434): An abnormally low concentration of maternal serum human chorionic gonadotropin as compared to normal values for gestational-age. Evidence: TAS. Frequency: Very frequent (HP:0040281). (ORPHA:99928)
- Metrorrhagia (HP:0100608): Bleeding at irregular intervals. Evidence: TAS. Frequency: Very frequent (HP:0040281). (ORPHA:99928)